Phenotypes associated with the disease hypertrophic cardiomyopathy 25 (OMIM:607487):
- Wolff-Parkinson-White syndrome (HP:0001716): A disorder of the cardiac conduction system of the heart characterized by ventricular preexcitation due to the presence of an abnormal accessory atrioventricular electrical conduction pathway. Evidence: PCS. Frequency: 1/2. (PMID:15582318)
- Hypertrophic cardiomyopathy (HP:0001639): Hypertrophic cardiomyopathy (HCM) is defined by the presence of increased ventricular wall thickness or mass in the absence of loading conditions (hypertension, valve disease) sufficient to cause the observed abnormality. Evidence: PCS. Frequency: 2/2. (PMID:15582318)
- Adult onset (HP:0003581): Onset of disease manifestations in adulthood, defined here as at the age of 16 years or later. Evidence: PCS. Frequency: 2/2. (PMID:15582318)
- Left ventricular hypertrophy (HP:0001712): Enlargement or increased size of the heart left ventricle. Evidence: PCS. Frequency: 2/2. (PMID:15582318)
- Autosomal dominant inheritance (HP:0000006): A mode of inheritance that is observed for traits related to a gene encoded on one of the autosomes (i.e., the human chromosomes 1-22) in which a trait manifests in heterozygotes. In the context of medical genetics, an autosomal dominant disorder is caused when a single copy of the mutant allele is present. Males and females are affected equally, and can both transmit the disorder with a risk of 50% for each child of inheriting the mutant allele. Evidence: PCS. (PMID:15582318)